Phenotypes associated with the disease spermatogenic failure, X-linked, 8 (OMIM:301119):
- Reduced progressive sperm motility (HP:0034011): A reduced proportion of sperm that move in a straight line or large circles; alternatively, an increased proportion of sperm that move in tight circles or in some other non-linear fashion. Evidence: PCS. Frequency: 2/2. (PMID:38013430;PMID:38573307)
- Coiled sperm flagella (HP:0032560): Sperm cells whose flagella are twisted (coiled). Evidence: PCS. Frequency: 1/1. (PMID:38013430)
- Male infertility (HP:0003251). Evidence: PCS. Frequency: 2/2. (PMID:38013430;PMID:38573307)
- Young adult onset (HP:0011462): Onset of disease at the age of between 16 and 40 years. Evidence: PCS. Frequency: 2/2. (PMID:38013430;PMID:38573307)
- X-linked inheritance (HP:0001417): A mode of inheritance that is observed for traits related to a gene encoded on the X chromosome. Evidence: PCS. (PMID:38013430)
- Oligozoospermia (HP:0000798): Reduced count of spermatozoa in the semen, defined as a sperm count below 20 million per milliliter semen. Evidence: PCS. Frequency: 2/2. (PMID:38013430;PMID:38573307)
- Abnormal sperm head morphology (HP:0012865): A structural abnormality of the sperm head. Evidence: PCS. Frequency: 2/2. (PMID:38013430;PMID:38573307)